- Abnormal vestibular function (HP:0001751): An abnormality of the functioning of the vestibular apparatus. Evidence: PCS. Frequency: 0/9. (PMID:24729547)
- Young adult onset (HP:0011462): Onset of disease at the age of between 16 and 40 years. Evidence: PCS. Frequency: 19/19. (PMID:24729547;PMID:24729539)
- Progressive hearing impairment (HP:0001730): A progressive form of hearing impairment. Evidence: PCS. Frequency: 19/19. Onset: Young adult onset (HP:0011462). (PMID:24729547;PMID:24729539)
- Autosomal dominant inheritance (HP:0000006): A mode of inheritance that is observed for traits related to a gene encoded on one of the autosomes (i.e., the human chromosomes 1-22) in which a trait manifests in heterozygotes. In the context of medical genetics, an autosomal dominant disorder is caused when a single copy of the mutant allele is present. Males and females are affected equally, and can both transmit the disorder with a risk of 50% for each child of inheriting the mutant allele. Evidence: PCS. (PMID:24729539)
- Slowly progressive (HP:0003677): Applies to a disease manifestation that only slowly increases in scope or severity over the course of time. Evidence: PCS. (PMID:24729539)
These phenotypes are associated with the disease autosomal dominant nonsyndromic hearing loss 65 (OMIM:616044).